- Hepatic steatosis (HP:0001397): Steatosis is a term used to denote lipid accumulation within hepatocytes. Evidence: TAS. (OMIM:613282)
- Non-Mendelian inheritance (HP:0001426): A mode of inheritance that depends on genetic determinants in more than one gene. Evidence: TAS. (OMIM:613282)
These phenotypes are associated with the disease NAFLD1 (OMIM:613282).